Phenotypes associated with the disease type 1 diabetes mellitus 6 (OMIM:601941):
- Diabetes mellitus (HP:0000819): A group of abnormalities characterized by hyperglycemia and glucose intolerance. Evidence: IEA. (OMIM:601941)